- Abnormal eyelash morphology (HP:0000499): An abnormality of the eyelashes. Evidence: TAS. Frequency: Very frequent (HP:0040281). (ORPHA:3437)
- Abnormal eyebrow morphology (HP:0000534): An abnormality of the eyebrow. Evidence: TAS. Frequency: Very frequent (HP:0040281). (ORPHA:3437)
- Vitiligo (HP:0001045). Evidence: TAS. Frequency: Very frequent (HP:0040281). (ORPHA:3437)
- Hypopigmented skin patches (HP:0001053). Evidence: TAS. Frequency: Very frequent (HP:0040281). (ORPHA:3437)
- Sparse scalp hair (HP:0002209): Decreased number of hairs per unit area of skin of the scalp. Evidence: TAS. Frequency: Very frequent (HP:0040281). (ORPHA:3437)
- Premature graying of hair (HP:0002216): Development of gray hair at a younger than normal age. Evidence: TAS. Frequency: Very frequent (HP:0040281). (ORPHA:3437)
- Poliosis (HP:0002290): Circumscribed depigmentation of the hair of the head or the eyelashes. Evidence: TAS. Frequency: Very frequent (HP:0040281). (ORPHA:3437)
- Headache (HP:0002315): Cephalgia, or pain sensed in various parts of the head, not confined to the area of distribution of any nerve. Evidence: TAS. Frequency: Very frequent (HP:0040281). (ORPHA:3437)
- CSF pleocytosis (HP:0012229): An increased white blood cell count in the cerebrospinal fluid. Evidence: TAS. Frequency: Very frequent (HP:0040281). (ORPHA:3437)
- Cognitive impairment (HP:0100543): Abnormal cognition is characterized by deficits in thinking, reasoning, or remembering. Evidence: TAS. Frequency: Very frequent (HP:0040281). (ORPHA:3437)
- Tinnitus (HP:0000360): Tinnitus is an auditory perception that can be described as the experience of sound, in the ear or in the head, in the absence of external acoustic stimulation. Evidence: TAS. Frequency: Frequent (HP:0040282). (ORPHA:3437)
- Sensorineural hearing impairment (HP:0000407): A type of hearing impairment in one or both ears related to an abnormal functionality of the cochlear nerve. Evidence: TAS. Frequency: Frequent (HP:0040282). (ORPHA:3437)
- Visual impairment (HP:0000505): Visual impairment (or vision impairment) is vision loss (of a person) to such a degree as to qualify as an additional support need through a significant limitation of visual capability resulting from either disease, trauma, or congenital or degenerative conditions that cannot be corrected by conventional means, such as refractive correction, medication, or surgery. Evidence: TAS. Frequency: Frequent (HP:0040282). (ORPHA:3437)
- Cataract (HP:0000518): A cataract is an opacity or clouding that develops in the crystalline lens of the eye or in its capsule. Evidence: TAS. Frequency: Frequent (HP:0040282). (ORPHA:3437)
- Retinal detachment (HP:0000541): Separation of the inner layers of the retina (neural retina) from the pigment epithelium. Evidence: TAS. Frequency: Frequent (HP:0040282). (ORPHA:3437)
- Uveitis (HP:0000554): Inflammation of one or all portions of the uveal tract. Evidence: TAS. Frequency: Frequent (HP:0040282). (ORPHA:3437)
- Blurred vision (HP:0000622): Lack of sharpness of vision resulting in the inability to see fine detail. Evidence: TAS. Frequency: Frequent (HP:0040282). (ORPHA:3437)
- Iridocyclitis (HP:0001094): A type of anterior uveitis, in which there is Inflammation of the iris and the ciliary body. Evidence: TAS. Frequency: Frequent (HP:0040282). (ORPHA:3437)
- Short stature (HP:0004322): A height below that which is expected according to age and gender norms. Although there is no universally accepted definition of short stature, many refer to "short stature" as height more than 2 standard deviations below the mean for age and gender (or below the 3rd percentile for age and gender dependent norms). Evidence: TAS. Frequency: Frequent (HP:0040282). (ORPHA:3437)
- Posterior subcapsular cataract (HP:0007787): A type of cataract affecting the posterior pole of lens immediately adjacent to ('beneath') the Lens capsule. Evidence: TAS. Frequency: Frequent (HP:0040282). (ORPHA:3437)
- Ocular hypertension (HP:0007906): Intraocular pressure that is 2 standard deviations above the population mean. Evidence: TAS. Frequency: Frequent (HP:0040282). (ORPHA:3437)
- Retinal nerve fiber edema (HP:0020120): Swelling (edema) of the retinal nerve fibers. Evidence: TAS. Frequency: Frequent (HP:0040282). (ORPHA:3437)
- Conjunctival hyperemia (HP:0030953): Dilatation of the blood vessels of the conjunctiva leading to a red appearance of the sclera. Evidence: TAS. Frequency: Frequent (HP:0040282). (ORPHA:3437)
- Nuchal rigidity (HP:0031179): Resistance of the extensor muscles of the neck to being bent forwards (i.e., impaired neck flexion) as a result of muscle spasm of the extensor muscles of the neck. Nuchal rigidity is not a fixed rigidity. Nuchal rigidity has been used as a bedside test for meningism, although its sensitivity for this purpose has been debated. Evidence: TAS. Frequency: Frequent (HP:0040282). (ORPHA:3437)
- Chorioretinal hypopigmentation (HP:0040030): Focal or global or heterogeneous loss of choroidal and retinal pigment epithelium (RPE) pigmentation in the absence of atrophy. Evidence: TAS. Frequency: Frequent (HP:0040282). (ORPHA:3437)
- Glaucoma (HP:0000501): Glaucoma refers loss of retinal ganglion cells in a characteristic pattern of optic neuropathy usually associated with increased intraocular pressure. Evidence: TAS. Frequency: Occasional (HP:0040283). (ORPHA:3437)
- Photophobia (HP:0000613): Excessive sensitivity to light with the sensation of discomfort or pain in the eyes due to exposure to bright light. Evidence: TAS. Frequency: Occasional (HP:0040283). (ORPHA:3437)
- Alopecia (HP:0001596): A noncongenital process of hair loss, which may progress to partial or complete baldness. Evidence: TAS. Frequency: Occasional (HP:0040283). (ORPHA:3437)
- Fever (HP:0001945): Body temperature elevated above the normal range. Evidence: TAS. Frequency: Occasional (HP:0040283). (ORPHA:3437)
- Nausea (HP:0002018): A sensation of unease in the stomach together with an urge to vomit. Evidence: TAS. Frequency: Occasional (HP:0040283). (ORPHA:3437)
- Vertigo (HP:0002321): An abnormal sensation of spinning while the body is actually stationary. Evidence: TAS. Frequency: Occasional (HP:0040283). (ORPHA:3437)
- Aphasia (HP:0002381): An acquired language impairment of some or all of the abilities to produce or comprehend speech and to read or write. Evidence: TAS. Frequency: Occasional (HP:0040283). (ORPHA:3437)
- Epiphora (HP:0009926): Abnormally increased lacrimation, that is, excessive tearing (watering eye). Evidence: TAS. Frequency: Occasional (HP:0040283). (ORPHA:3437)
- Posterior synechiae of the anterior chamber (HP:0011484): Adhesions between the iris and the lens. Evidence: TAS. Frequency: Occasional (HP:0040283). (ORPHA:3437)
- Corneal keratic precipitates (HP:0025341): An inflammatory cellular deposit deposited on the corneal endothelium and visible as spots on the cornea. Evidence: TAS. Frequency: Occasional (HP:0040283). (ORPHA:3437)
- Scalp tenderness (HP:0100809): Pain or discomfort of the scalp elicited by palpation. Evidence: TAS. Frequency: Occasional (HP:0040283). (ORPHA:3437)
- Dalen-Fuchs nodules (HP:6000710): Nodules (yellow-white subretinal pigment epithelium lesions) that form between Bruch membrane and the retinal pigment epithelium. Evidence: TAS. Frequency: Occasional (HP:0040283). (ORPHA:3437)
These phenotypes are associated with the disease Vogt-Koyanagi-Harada disease (ORPHA:3437).